Phenotypes associated with the disease autosomal recessive nonsyndromic hearing loss 25 (OMIM:613285):
- Congenital onset (HP:0003577): A phenotypic abnormality that is present at birth. Evidence: PCS. Frequency: 10/10. (PMID:20137778)
- Hearing impairment (HP:0000365): A decreased magnitude of the sensory perception of sound. Evidence: TAS. Frequency: 10/10. (PMID:20137778)
- Abnormal vestibular function (HP:0001751): An abnormality of the functioning of the vestibular apparatus. Evidence: PCS. Frequency: 0/4. (PMID:20137778)
- Progressive sensorineural hearing impairment (HP:0000408): A progressive form of sensorineural hearing impairment. Evidence: TAS. Frequency: 3/10. (PMID:20137778)
- Autosomal recessive inheritance (HP:0000007): A mode of inheritance that is observed for traits related to a gene encoded on one of the autosomes (i.e., the human chromosomes 1-22) in which a trait manifests in individuals with two pathogenic alleles, either homozygotes (two copies of the same mutant allele) or compound heterozygotes (whereby each copy of a gene has a distinct mutant allele). Evidence: IEA. (OMIM:613285)